- Coiled sperm flagella (HP:0032560): Sperm cells whose flagella are twisted (coiled). Evidence: PCS. (PMID:29606301)
- Microcephalic sperm head (HP:0032561): Decreased size of the head of sperm. Evidence: PCS. (PMID:29606301)
- Tapered sperm head (HP:0032562): Sperm with cigar-shaped heads that gradually dimish in diameter (taper). Evidence: PCS. (PMID:29606301)
- Autosomal recessive inheritance (HP:0000007): A mode of inheritance that is observed for traits related to a gene encoded on one of the autosomes (i.e., the human chromosomes 1-22) in which a trait manifests in individuals with two pathogenic alleles, either homozygotes (two copies of the same mutant allele) or compound heterozygotes (whereby each copy of a gene has a distinct mutant allele). Evidence: PCS. (PMID:29606301)
- Reduced sperm motility (HP:0012207): An abnormal reduction in the mobility of ejaculated sperm. Evidence: TAS. Frequency: 2/2. (PMID:29606301)
- Short sperm flagella (HP:0032559): Sperm cells with abnormally short flagella. Evidence: PCS. (PMID:29606301)
These phenotypes are associated with the disease spermatogenic failure 24 (OMIM:617959).